Phenotypes associated with the disease Acromesomelic dysplasia, Maroteaux type (ORPHA:40):
- Joint hypermobility (HP:0001382): The capability that a joint (or a group of joints) has to move, passively and/or actively, beyond normal limits along physiological axes. Evidence: TAS. Frequency: Frequent (HP:0040282). (ORPHA:40)
- Dolichocephaly (HP:0000268): An abnormality of skull shape characterized by a increased anterior-posterior diameter, i.e., an increased antero-posterior dimension of the skull. Cephalic index less than 76%. Alternatively, an apparently increased antero-posterior length of the head compared to width. Often due to premature closure of the sagittal suture. Evidence: TAS. Frequency: Frequent (HP:0040282). (ORPHA:40)
- Sprengel anomaly (HP:0000912): A congenital skeletal deformity characterized by the elevation of one scapula (thus, one scapula is located superior to the other). Evidence: TAS. Frequency: Frequent (HP:0040282). (ORPHA:40)
- Brachydactyly (HP:0001156): Digits that appear disproportionately short compared to the hand/foot. The word brachydactyly is used here to describe a series distinct patterns of shortened digits (brachydactyly types A-E). This is the sense used here. Evidence: TAS. Frequency: Frequent (HP:0040282). (ORPHA:40)
- Joint stiffness (HP:0001387): Joint stiffness is a perceived sensation of tightness in a joint or joints when attempting to move them after a period of inactivity. Joint stiffness typically subsides over time. Evidence: TAS. Frequency: Frequent (HP:0040282). (ORPHA:40)
- Frontal bossing (HP:0002007): Bilateral bulging of the lateral frontal bone prominences with relative sparing of the midline. Evidence: TAS. Frequency: Frequent (HP:0040282). (ORPHA:40)
- Scoliosis (HP:0002650): The presence of an abnormal lateral curvature of the spine. Evidence: TAS. Frequency: Frequent (HP:0040282). (ORPHA:40)
- Kyphosis (HP:0002808): Exaggerated anterior convexity of the thoracic vertebral column. Evidence: TAS. Frequency: Frequent (HP:0040282). (ORPHA:40)
- Acromesomelia (HP:0003086): Small hands and feet. Evidence: TAS. Frequency: Frequent (HP:0040282). (ORPHA:40)
- Ovoid vertebral bodies (HP:0003300): When viewed in lateral radiographs, vertebral bodies have a roughly rectangular configuration. This term applies if the vertebral body appears rounded or oval. Evidence: TAS. Frequency: Frequent (HP:0040282). (ORPHA:40)
- Hyperlordosis (HP:0003307): Abnormally increased curvature (anterior concavity) of the lumbar or cervical spine. Evidence: TAS. Frequency: Frequent (HP:0040282). (ORPHA:40)
- Abnormal vertebral body morphology (HP:0003312): Abnormal form of vertebral body, which is the central cylindrical portion of the vertebra that together with other structures such as the vertebral arch, pedicles, laminae, spinous process, transverse processes, and articular facets makes up a vertebra. Evidence: TAS. Frequency: Frequent (HP:0040282). (ORPHA:40)
- Disproportionate short stature (HP:0003498): A kind of short stature in which different regions of the body are shortened to differing extents. Evidence: TAS. Frequency: Frequent (HP:0040282). (ORPHA:40)
- Beaking of vertebral bodies (HP:0004568): Anterior tongue-like protrusions of the vertebral bodies. Evidence: TAS. Frequency: Frequent (HP:0040282). (ORPHA:40)
- Depressed nasal bridge (HP:0005280): Posterior positioning of the nasal root in relation to the overall facial profile for age. Evidence: TAS. Frequency: Frequent (HP:0040282). (ORPHA:40)
- Bowing of the long bones (HP:0006487): A bending or abnormal curvature of a long bone. Evidence: TAS. Frequency: Frequent (HP:0040282). (ORPHA:40)
- Vertebral wedging (HP:0008422): An abnormal shape of the vertebral bodies whereby the vertebral bodies are thick on one side and taper to a thin edge at the other. Evidence: TAS. Frequency: Frequent (HP:0040282). (ORPHA:40)
- Prominent forehead (HP:0011220): Forward prominence of the entire forehead, due to protrusion of the frontal bone. Evidence: TAS. Frequency: Frequent (HP:0040282). (ORPHA:40)